- Myokymia (HP:0002411): Myokymia consists of involuntary, fine, continuous, undulating contractions that spread across the affected striated muscle. Evidence: IEA. (OMIM:606554)
- Diplopia (HP:0000651): Diplopia is a condition in which a single object is perceived as two images, it is also known as double vision. Evidence: IEA. (OMIM:606554)
- Vomiting (HP:0002013): Forceful ejection of the contents of the stomach through the mouth by means of a series of involuntary spasmic contractions. Evidence: IEA. (OMIM:606554)
- Vertigo (HP:0002321): An abnormal sensation of spinning while the body is actually stationary. Evidence: IEA. (OMIM:606554)
- Episodic ataxia (HP:0002131): Periodic spells of incoordination and imbalance, that is, episodes of ataxia typically lasting from 10 minutes to several hours or days. Evidence: IEA. (OMIM:606554)
- Tinnitus (HP:0000360): Tinnitus is an auditory perception that can be described as the experience of sound, in the ear or in the head, in the absence of external acoustic stimulation. Evidence: IEA. (OMIM:606554)
- Muscle weakness (HP:0001324): Reduced strength of muscles. Evidence: IEA. (OMIM:606554)
- Nausea (HP:0002018): A sensation of unease in the stomach together with an urge to vomit. Evidence: IEA. (OMIM:606554)
- Headache (HP:0002315): Cephalgia, or pain sensed in various parts of the head, not confined to the area of distribution of any nerve. Evidence: IEA. (OMIM:606554)
- Autosomal dominant inheritance (HP:0000006): A mode of inheritance that is observed for traits related to a gene encoded on one of the autosomes (i.e., the human chromosomes 1-22) in which a trait manifests in heterozygotes. In the context of medical genetics, an autosomal dominant disorder is caused when a single copy of the mutant allele is present. Males and females are affected equally, and can both transmit the disorder with a risk of 50% for each child of inheriting the mutant allele. Evidence: IEA. (OMIM:606554)
These phenotypes are associated with the disease episodic ataxia type 3 (OMIM:606554).